Phenotypes associated with the disease Acrodysostosis (ORPHA:950):
- Open mouth (HP:0000194): A facial appearance characterized by a permanently or nearly permanently opened mouth. Evidence: TAS. Frequency: Very frequent (HP:0040281). (ORPHA:950)
- Hypoplasia of the maxilla (HP:0000327): Abnormally small dimension of the Maxilla. Usually creating a malocclusion or malalignment between the upper and lower teeth or resulting in a deficient amount of projection of the base of the nose and lower midface region. Evidence: TAS. Frequency: Very frequent (HP:0040281). (ORPHA:950)
- Wide nasal bridge (HP:0000431): Increased breadth of the nasal bridge (and with it, the nasal root). Evidence: TAS. Frequency: Very frequent (HP:0040281). (ORPHA:950)
- Depressed nasal ridge (HP:0000457): Lack of prominence of the nose resulting from a posteriorly-placed nasal ridge. Evidence: TAS. Frequency: Very frequent (HP:0040281). (ORPHA:950)
- Brachydactyly (HP:0001156): Digits that appear disproportionately short compared to the hand/foot. The word brachydactyly is used here to describe a series distinct patterns of shortened digits (brachydactyly types A-E). This is the sense used here. Evidence: TAS. Frequency: Very frequent (HP:0040281). (ORPHA:950)
- Intellectual disability (HP:0001249): The term intellectual disability or intellectual developmental disorder is used to describe significantly sub-average intellectual and adaptive functioning based on clinical assessment and as measured by individually administered, appropriately normed, standardized and validated tests of intellectual functioning and adaptive behavior, with onset during the developmental period from infancy through adolescence. Evidence: TAS. Frequency: Very frequent (HP:0040281). (ORPHA:950)
- Abnormal nail morphology (HP:0001597): Abnormal structure or appearance of the nail. Evidence: TAS. Frequency: Very frequent (HP:0040281). (ORPHA:950)
- Short toe (HP:0001831): A toe that appears disproportionately short compared to the foot. Evidence: TAS. Frequency: Very frequent (HP:0040281). (ORPHA:950)
- Short nose (HP:0003196): Distance from nasion to subnasale more than two standard deviations below the mean, or alternatively, an apparently decreased length from the nasal root to the nasal tip. Evidence: TAS. Frequency: Very frequent (HP:0040281). (ORPHA:950)
- Abnormal vertebral body morphology (HP:0003312): Abnormal form of vertebral body, which is the central cylindrical portion of the vertebra that together with other structures such as the vertebral arch, pedicles, laminae, spinous process, transverse processes, and articular facets makes up a vertebra. Evidence: TAS. Frequency: Very frequent (HP:0040281). (ORPHA:950)
- Short stature (HP:0004322): A height below that which is expected according to age and gender norms. Although there is no universally accepted definition of short stature, many refer to "short stature" as height more than 2 standard deviations below the mean for age and gender (or below the 3rd percentile for age and gender dependent norms). Evidence: TAS. Frequency: Very frequent (HP:0040281). (ORPHA:950)
- Depressed nasal bridge (HP:0005280): Posterior positioning of the nasal root in relation to the overall facial profile for age. Evidence: TAS. Frequency: Very frequent (HP:0040281). (ORPHA:950)
- Accelerated skeletal maturation (HP:0005616): An abnormally increased rate of skeletal maturation. Accelerated skeletal maturation can be diagnosed on the basis of an estimation of the bone age from radiographs of specific bones in the human body. Evidence: TAS. Frequency: Very frequent (HP:0040281). (ORPHA:950)
- Abnormal metacarpal morphology (HP:0005916): Any abnormal shape or structure of the metacarpal bones. Evidence: TAS. Frequency: Very frequent (HP:0040281). (ORPHA:950)
- Short metacarpal (HP:0010049): Diminished length of one or more metacarpal bones in relation to the others of the same hand or to the contralateral metacarpal. Evidence: TAS. Frequency: Very frequent (HP:0040281). (ORPHA:950)
- Cone-shaped epiphysis (HP:0010579): Cone-shaped epiphyses (also known as coned epiphyses) are epiphyses that invaginate into cupped metaphyses. That is, the epiphysis has a cone-shaped distal extension resulting from increased growth of the central portion of the epiphysis relative to its periphery. Evidence: TAS. Frequency: Very frequent (HP:0040281). (ORPHA:950)
- Epiphyseal stippling (HP:0010655): The presence of abnormal punctate (speckled, dot-like) calcifications in one or more epiphyses. Evidence: TAS. Frequency: Very frequent (HP:0040281). (ORPHA:950)
- Short metatarsal (HP:0010743): Diminished length of a metatarsal bone, with resultant proximal displacement of the associated toe. Evidence: TAS. Frequency: Very frequent (HP:0040281). (ORPHA:950)
- Midface retrusion (HP:0011800): Posterior positions and/or vertical shortening of the infraorbital and perialar regions, or increased concavity of the face and/or reduced nasolabial angle. Evidence: TAS. Frequency: Very frequent (HP:0040281). (ORPHA:950)
- Cryptorchidism (HP:0000028): Testis in inguinal canal. That is, absence of one or both testes from the scrotum owing to failure of the testis or testes to descend through the inguinal canal to the scrotum. Evidence: TAS. Frequency: Frequent (HP:0040282). (ORPHA:950)
- Abnormal female external genitalia morphology (HP:0000055): Any structural abnormality of the female external genitalia. Evidence: TAS. Frequency: Frequent (HP:0040282). (ORPHA:950)
- Brachycephaly (HP:0000248): An abnormality of skull shape characterized by a decreased anterior-posterior diameter. That is, a cephalic index greater than 81%. Alternatively, an apparently shortened anteroposterior dimension (length) of the head compared to width. Evidence: TAS. Frequency: Frequent (HP:0040282). (ORPHA:950)
- Mandibular prognathia (HP:0000303): Abnormal prominence of the chin related to increased length of the mandible. Evidence: TAS. Frequency: Frequent (HP:0040282). (ORPHA:950)
- Hypertelorism (HP:0000316): Interpupillary distance more than 2 SD above the mean (alternatively, the appearance of an increased interpupillary distance or widely spaced eyes). Evidence: TAS. Frequency: Frequent (HP:0040282). (ORPHA:950)
- Hearing impairment (HP:0000365): A decreased magnitude of the sensory perception of sound. Evidence: TAS. Frequency: Frequent (HP:0040282). (ORPHA:950)
- Anteverted nares (HP:0000463): Anteriorly-facing nostrils viewed with the head in the Frankfurt horizontal and the eyes of the observer level with the eyes of the subject. This gives the appearance of an upturned nose (upturned nasal tip). Evidence: TAS. Frequency: Frequent (HP:0040282). (ORPHA:950)
- Telecanthus (HP:0000506): Distance between the inner canthi more than two standard deviations above the mean (objective); or, apparently increased distance between the inner canthi. Evidence: TAS. Frequency: Frequent (HP:0040282). (ORPHA:950)
- Delayed eruption of teeth (HP:0000684): Delayed tooth eruption, which can be defined as tooth eruption more than 2 SD beyond the mean eruption age. Evidence: TAS. Frequency: Frequent (HP:0040282). (ORPHA:950)
- Abnormal diaphysis morphology (HP:0000940): An abnormality of the structure or form of the diaphysis, i.e., of the main or mid-section (shaft) of a long bone. Evidence: TAS. Frequency: Frequent (HP:0040282). (ORPHA:950)
- Abnormal metaphysis morphology (HP:0000944): An abnormality of one or more metaphysis, i.e., of the somewhat wider portion of a long bone that is adjacent to the epiphyseal growth plate and grows during childhood. Evidence: TAS. Frequency: Frequent (HP:0040282). (ORPHA:950)
- Joint dislocation (HP:0001373): Displacement or malalignment of joints. Evidence: TAS. Frequency: Frequent (HP:0040282). (ORPHA:950)
- Frontal bossing (HP:0002007): Bilateral bulging of the lateral frontal bone prominences with relative sparing of the midline. Evidence: TAS. Frequency: Frequent (HP:0040282). (ORPHA:950)
- Coxa valga (HP:0002673): Coxa valga is a deformity of the hip in which the angle between the femoral shaft and the femoral neck is increased compared to age-adjusted values (about 150 degrees in newborns gradually reducing to 120-130 degrees in adults). Evidence: TAS. Frequency: Frequent (HP:0040282). (ORPHA:950)
- Abnormal morphology of the radius (HP:0002818): An abnormality of the radius. Evidence: TAS. Frequency: Frequent (HP:0040282). (ORPHA:950)
- Abnormal femur morphology (HP:0002823): Any anomaly of the structure of the femur. Evidence: TAS. Frequency: Frequent (HP:0040282). (ORPHA:950)
- Genu varum (HP:0002970): A positional abnormality marked by outward bowing of the legs in which the knees stay wide apart when a person stands with the feet and ankles together. Evidence: TAS. Frequency: Frequent (HP:0040282). (ORPHA:950)
- Micromelia (HP:0002983): The presence of abnormally small extremities. Evidence: TAS. Frequency: Frequent (HP:0040282). (ORPHA:950)
- Hypoplasia of the radius (HP:0002984): Underdevelopment of the radius. Evidence: TAS. Frequency: Frequent (HP:0040282). (ORPHA:950)
- Hypoplasia of the ulna (HP:0003022): Underdevelopment of the ulna. Evidence: TAS. Frequency: Frequent (HP:0040282). (ORPHA:950)
- Spinal canal stenosis (HP:0003416): An abnormal narrowing of the spinal canal. Evidence: TAS. Frequency: Frequent (HP:0040282). (ORPHA:950)
- Cone-shaped metacarpal epiphyses (HP:0006059): A cone-shaped appearance of the epiphyses of the metacarpal bones, producing a 'ball-in-a-socket' appearance. This epiphyses are located at the distal ends of the metacarpal bones. Evidence: TAS. Frequency: Frequent (HP:0040282). (ORPHA:950)
- Bowing of the long bones (HP:0006487): A bending or abnormal curvature of a long bone. Evidence: TAS. Frequency: Frequent (HP:0040282). (ORPHA:950)
- Peripheral neuropathy (HP:0009830): Peripheral neuropathy is a general term for any disorder of the peripheral nervous system. The main clinical features used to classify peripheral neuropathy are distribution, type (mainly demyelinating versus mainly axonal), duration, and course. Evidence: TAS. Frequency: Frequent (HP:0040282). (ORPHA:950)
- Abnormality of immune system physiology (HP:0010978): A functional abnormality of the immune system. Evidence: TAS. Frequency: Frequent (HP:0040282). (ORPHA:950)
- Prominent forehead (HP:0011220): Forward prominence of the entire forehead, due to protrusion of the frontal bone. Evidence: TAS. Frequency: Frequent (HP:0040282). (ORPHA:950)
- Abnormal morphology of ulna (HP:0040071): Any structural anomaly of the ulna, a bone of the forearm the extends from the elbow to the little finger. Evidence: TAS. Frequency: Frequent (HP:0040282). (ORPHA:950)
- Hypogonadism (HP:0000135): A decreased functionality of the gonad. Evidence: TAS. Frequency: Occasional (HP:0040283). (ORPHA:950)
- Epicanthus (HP:0000286): A fold of skin starting above the medial aspect of the upper eyelid and arching downward to cover, pass in front of and lateral to the medial canthus. Evidence: TAS. Frequency: Occasional (HP:0040283). (ORPHA:950)
- Irregular menstruation (HP:0000858): Abnormally high variation in the amount of time between periods. Evidence: TAS. Frequency: Occasional (HP:0040283). (ORPHA:950)
- Melanocytic nevus (HP:0000995): A oval and round, colored (usually medium-to dark brown, reddish brown, or flesh colored) lesion. Typically, a melanocytic nevus is less than 6 mm in diameter, but may be much smaller or larger. Evidence: TAS. Frequency: Occasional (HP:0040283). (ORPHA:950)
- Scoliosis (HP:0002650): The presence of an abnormal lateral curvature of the spine. Evidence: TAS. Frequency: Occasional (HP:0040283). (ORPHA:950)
- Open bite (HP:0010807): Visible space between the dental arches in occlusion. Evidence: TAS. Frequency: Occasional (HP:0040283). (ORPHA:950)
- Flat face (HP:0012368): Absence of concavity or convexity of the face when viewed in profile. Evidence: TAS. Frequency: Occasional (HP:0040283). (ORPHA:950)